Phenotypes associated with the disease mitochondrial complex I deficiency, nuclear type 19 (OMIM:618241):
- Poor speech (HP:0002465). Evidence: IEA. (OMIM:618241)
- Congenital onset (HP:0003577): A phenotypic abnormality that is present at birth. Evidence: PCS. Frequency: 1/1. (PMID:20818383)
- Inability to walk (HP:0002540): Incapability to ambulate. Evidence: PCS. Frequency: 1/1. (PMID:20858599)
- Seizure (HP:0001250): A seizure is an intermittent abnormality of nervous system physiology characterized by a transient occurrence of signs and/or symptoms due to abnormal excessive or synchronous neuronal activity in the brain. Evidence: IEA. (OMIM:618241)
- Cerebellar atrophy (HP:0001272): Cerebellar atrophy is defined as a cerebellum with initially normal structures, in a posterior fossa with normal size, which displays enlarged fissures (interfolial spaces) in comparison to the foliae secondary to loss of tissue. Cerebellar atrophy implies irreversible loss of tissue and result from an ongoing progressive disease until a final stage is reached or a single injury, e.g. an intoxication or infectious event. Evidence: PCS. Frequency: 1/1. (PMID:20818383)
- Rigidity (HP:0002063): Continuous involuntary sustained muscle contraction. When an affected muscle is passively stretched, the degree of resistance remains constant regardless of the rate at which the muscle is stretched. This feature helps to distinguish rigidity from muscle spasticity. Evidence: IEA. (OMIM:618241)
- Hypotonia (HP:0001252): Hypotonia is an abnormally low muscle tone (the amount of tension or resistance to movement in a muscle). Even when relaxed, muscles have a continuous and passive partial contraction which provides some resistance to passive stretching. Hypotonia thus manifests as diminished resistance to passive stretching. Hypotonia is not the same as muscle weakness, although the two conditions can co-exist. Evidence: PCS. Frequency: 1/1. (PMID:20818383)
- Hypotonia (HP:0001252): Hypotonia is an abnormally low muscle tone (the amount of tension or resistance to movement in a muscle). Even when relaxed, muscles have a continuous and passive partial contraction which provides some resistance to passive stretching. Hypotonia thus manifests as diminished resistance to passive stretching. Hypotonia is not the same as muscle weakness, although the two conditions can co-exist. Evidence: PCS. Frequency: 1/1. Onset: Neonatal onset (HP:0003623). (PMID:20858599)
- Delayed myelination (HP:0012448): Delayed myelination. Evidence: IEA. (OMIM:618241)
- Irritability (HP:0000737): An emotional state characterized by negative feelings of heightened frustration, annoyance, or feeling upset, often triggered by internal factors (e.g., fatigue, hunger, unfulfilled desires) or external factors (e.g., social or environmental challenges). Irritability may be unpredictable, and is accompanied by a lowered threshold for emotional reactivity and observable features (speech, facial expressions, or psychomotor activity). Evidence: PCS. Frequency: 1/1. (PMID:20858599)
- Cerebral visual impairment (HP:0100704): A form of loss of vision caused by damage to the visual cortex rather than a defect in the eye. Evidence: PCS. Frequency: 1/1. (PMID:20858599)
- Hypoglycemia (HP:0001943): A decreased concentration of glucose in the blood. Evidence: IEA. (OMIM:618241)
- Ventriculomegaly (HP:0002119): An increase in size of the ventricular system of the brain. Evidence: IEA. (OMIM:618241)
- Neonatal onset (HP:0003623): Onset of signs or symptoms of disease within the first 28 days of life. Evidence: PCS. Frequency: 1/1. (PMID:20858599)
- Lactic acidosis (HP:0003128): An abnormal buildup of lactic acid in the body, leading to acidification of the blood and other bodily fluids. Evidence: PCS. Frequency: 1/1. Onset: Congenital onset (HP:0003577). (PMID:20818383)
- Scoliosis (HP:0002650): The presence of an abnormal lateral curvature of the spine. Evidence: IEA. (OMIM:618241)
- Absent speech (HP:0001344): Complete lack of development of speech and language abilities. Evidence: PCS. Frequency: 1/1. (PMID:20818383)
- Gait disturbance (HP:0001288): The term gait disturbance can refer to any disruption of the ability to walk. Evidence: IEA. (OMIM:618241)
- Feeding difficulties (HP:0011968): Impaired ability to eat related to problems gathering food and getting ready to suck, chew, or swallow it. Evidence: IEA. (OMIM:618241)
- Global developmental delay (HP:0001263): A delay in the achievement of motor or mental milestones in the domains of development of a child, including motor skills, speech and language, cognitive skills, and social and emotional skills. This term should only be used to describe children younger than five years of age. Evidence: PCS. Frequency: 1/1. (PMID:20858599)
- Secondary microcephaly (HP:0005484): Head circumference which falls below 2 standard deviations below the mean for age and gender because of insufficient head growth after birth. Evidence: PCS. Frequency: 1/1. (PMID:20858599)
- Respiratory insufficiency (HP:0002093). Evidence: IEA. (OMIM:618241)
- Decreased activity of mitochondrial complex I (HP:0011923): A reduction in the activity of the mitochondrial respiratory chain complex I, which is part of the electron transport chain in mitochondria. Evidence: PCS. Frequency: 2/2. (PMID:20818383;PMID:20858599)
- Hypertrophic cardiomyopathy (HP:0001639): Hypertrophic cardiomyopathy (HCM) is defined by the presence of increased ventricular wall thickness or mass in the absence of loading conditions (hypertension, valve disease) sufficient to cause the observed abnormality. Evidence: PCS. Frequency: 1/1. (PMID:20858599)
- Autosomal recessive inheritance (HP:0000007): A mode of inheritance that is observed for traits related to a gene encoded on one of the autosomes (i.e., the human chromosomes 1-22) in which a trait manifests in individuals with two pathogenic alleles, either homozygotes (two copies of the same mutant allele) or compound heterozygotes (whereby each copy of a gene has a distinct mutant allele). Evidence: PCS. (PMID:20818383)
- Optic atrophy (HP:0000648): Atrophy of the optic nerve. Optic atrophy results from the death of the retinal ganglion cell axons that comprise the optic nerve and manifesting as a pale optic nerve on fundoscopy. Evidence: IEA. Frequency: Very rare (HP:0040284). (OMIM:618241)
- Loss of ambulation (HP:0002505): Inability to walk in a person who previous had the ability to walk. Evidence: PCS. Frequency: 1/1. Onset: Juvenile onset (HP:0003621). (PMID:20818383)
- Athetosis (HP:0002305): A slow, continuous, involuntary writhing movement that prevents maintenance of a stable posture. Athetosis involves continuous smooth movements that appear random and are not composed of recognizable sub-movements or movement fragments. In contrast to chorea, in athetosis, the same regions of the body are repeatedly involved. Athetosis may worsen with attempts at movement of posture, but athetosis can also occur at rest. Evidence: PCS. Frequency: 1/1. (PMID:20818383)
- Myoclonus (HP:0001336): Very brief, involuntary random muscular contractions occurring at rest, in response to sensory stimuli, or accompanying voluntary movements. Evidence: IEA. (OMIM:618241)